- Autosomal recessive inheritance (HP:0000007): A mode of inheritance that is observed for traits related to a gene encoded on one of the autosomes (i.e., the human chromosomes 1-22) in which a trait manifests in individuals with two pathogenic alleles, either homozygotes (two copies of the same mutant allele) or compound heterozygotes (whereby each copy of a gene has a distinct mutant allele). Evidence: TAS. (OMIM:608219)
- Prelingual sensorineural hearing impairment (HP:0000399): A form of sensorineural deafness with either congenital onset or infantile onset, i.e., before the acquisition of speech. Evidence: TAS. (OMIM:608219)
These phenotypes are associated with the disease autosomal recessive nonsyndromic hearing loss 38 (OMIM:608219).